Phenotypes associated with the disease multiple cutaneous and mucosal venous malformations (OMIM:600195):
- Intestinal bleeding (HP:0002584): Bleeding from the intestines. Evidence: IEA. (OMIM:600195)
- Autosomal dominant inheritance (HP:0000006): A mode of inheritance that is observed for traits related to a gene encoded on one of the autosomes (i.e., the human chromosomes 1-22) in which a trait manifests in heterozygotes. In the context of medical genetics, an autosomal dominant disorder is caused when a single copy of the mutant allele is present. Males and females are affected equally, and can both transmit the disorder with a risk of 50% for each child of inheriting the mutant allele. Evidence: PCS. (PMID:8980225)
- Venous malformation (HP:0012721): A vascular malformation resulting from a developmental error of venous tissue composed of dysmorphic channels lined by flattened endothelium and exhibiting slow turnover. A venous malformation may present as a blue patch on the skin ranging to a soft blue mass. Venous malformations are easily compressible and usually swell in thewhen venous pressure increases (e.g., when held in a dependent position or when a child cries). They may be relatively localized or quite extensive within an anatomic region. Evidence: PCS. (PMID:10369874)